Phenotypes associated with the disease Isolated mesenteric vein thrombosis (ORPHA:583861):
- Abdominal pain (HP:0002027): An unpleasant sensation characterized by physical discomfort (such as pricking, throbbing, or aching) and perceived to originate in the abdomen. Evidence: TAS. Frequency: Very frequent (HP:0040281). (ORPHA:583861)
- Mesenteric venous thrombosis (HP:0030248): A clot that obstructs blood flow in a mesenteric vein (the superior and the inferior mesenteric vein drain blood from the small and large intestine). Evidence: TAS. Frequency: Very frequent (HP:0040281). (ORPHA:583861)
- Increased total leukocyte count (HP:0001974): An abnormal increase in the number of leukocytes in the blood. Evidence: TAS. Frequency: Frequent (HP:0040282). (ORPHA:583861)
- Vomiting (HP:0002013): Forceful ejection of the contents of the stomach through the mouth by means of a series of involuntary spasmic contractions. Evidence: TAS. Frequency: Frequent (HP:0040282). (ORPHA:583861)
- Diarrhea (HP:0002014): Abnormally increased frequency (usually defined as three or more) loose or watery bowel movements a day. Evidence: TAS. Frequency: Frequent (HP:0040282). (ORPHA:583861)
- Nausea (HP:0002018): A sensation of unease in the stomach together with an urge to vomit. Evidence: TAS. Frequency: Frequent (HP:0040282). (ORPHA:583861)
- Anorexia (HP:0002039): Lack of desire to eat (loss of appetite). Evidence: TAS. Frequency: Frequent (HP:0040282). (ORPHA:583861)
- Cholelithiasis (HP:0001081): Hard, pebble-like deposits that form within the gallbladder. Evidence: TAS. Frequency: Occasional (HP:0040283). (ORPHA:583861)
- Ascites (HP:0001541): Accumulation of fluid in the peritoneal cavity (between the layers of the peritoneum that lines the abdomen). Evidence: TAS. Frequency: Occasional (HP:0040283). (ORPHA:583861)
- Fever (HP:0001945): Body temperature elevated above the normal range. Evidence: TAS. Frequency: Occasional (HP:0040283). (ORPHA:583861)
- Increased circulating lactate concentration (HP:0002151): Abnormally increased level of blood lactate (2-hydroxypropanoic acid). Lactate is produced from pyruvate by lactate dehydrogenase during normal metabolism. The terms lactate and lactic acid are often used interchangeably but lactate (the component measured in blood) is strictly a weak base whereas lactic acid is the corresponding acid. Lactic acidosis is often used clinically to describe elevated lactate but should be reserved for cases where there is a corresponding acidosis (pH below 7.35). Evidence: TAS. Frequency: Occasional (HP:0040283). (ORPHA:583861)
- Gastrointestinal hemorrhage (HP:0002239): Hemorrhage affecting the gastrointestinal tract. Evidence: TAS. Frequency: Occasional (HP:0040283). (ORPHA:583861)
- Hypotension (HP:0002615): Low Blood Pressure, vascular hypotension. Evidence: TAS. Frequency: Occasional (HP:0040283). (ORPHA:583861)
- Abdominal distention (HP:0003270): Distention of the abdomen. Evidence: TAS. Frequency: Occasional (HP:0040283). (ORPHA:583861)
- Cholangitis (HP:0030151): Inflammation of the biliary ductal system, affecting the intrahepatic or extrahepatic portions, or both. Evidence: TAS. Frequency: Occasional (HP:0040283). (ORPHA:583861)
- Shock (HP:0031273): The state in which profound and widespread reduction of effective tissue perfusion leads first to reversible, and then if prolonged, to irreversible cellular injury. Evidence: TAS. Frequency: Occasional (HP:0040283). (ORPHA:583861)
- Sepsis (HP:0100806): Sepsis is defined as life-threatening organ dysfunction caused by a dysregulated host response to infection. Evidence: TAS. Frequency: Occasional (HP:0040283). (ORPHA:583861)
- Abnormal circulating amylase concentration (HP:0410282): Any deviation from the normal concentration of amylase in the blood circulation. Evidence: TAS. Frequency: Occasional (HP:0040283). (ORPHA:583861)
- Intramural intestinal gas (HP:6000377): The presence of extraluminal gas within the bowel wall. Evidence: TAS. Frequency: Occasional (HP:0040283). (ORPHA:583861)